- Rectovaginal fistula (HP:0000143): The presence of a fistula between the vagina and the rectum. Evidence: IEA. (OMIM:107100)
- Anal atresia (HP:0002023): Congenital absence of the anus, i.e., the opening at the bottom end of the intestinal tract. Evidence: IEA. (OMIM:107100)
- Autosomal dominant inheritance (HP:0000006): A mode of inheritance that is observed for traits related to a gene encoded on one of the autosomes (i.e., the human chromosomes 1-22) in which a trait manifests in heterozygotes. In the context of medical genetics, an autosomal dominant disorder is caused when a single copy of the mutant allele is present. Males and females are affected equally, and can both transmit the disorder with a risk of 50% for each child of inheriting the mutant allele. Evidence: IEA. (OMIM:107100)
These phenotypes are associated with the disease hereditary anorectal anomalies (OMIM:107100).